Phenotypes associated with the disease mitochondrial complex IV deficiency, nuclear type 14 (OMIM:619058):
- Epicanthus (HP:0000286): A fold of skin starting above the medial aspect of the upper eyelid and arching downward to cover, pass in front of and lateral to the medial canthus. Evidence: PCS. Frequency: 1/1. (PMID:25604084)
- Cognitive impairment (HP:0100543): Abnormal cognition is characterized by deficits in thinking, reasoning, or remembering. Evidence: PCS. Frequency: 1/1. (PMID:25604084)
- Short stature (HP:0004322): A height below that which is expected according to age and gender norms. Although there is no universally accepted definition of short stature, many refer to "short stature" as height more than 2 standard deviations below the mean for age and gender (or below the 3rd percentile for age and gender dependent norms). Evidence: PCS. Frequency: 1/1. (PMID:25604084)
- Sensorimotor neuropathy (HP:0007141). Evidence: PCS. Frequency: 1/1. (PMID:25604084)
- Deeply set eye (HP:0000490): An eye that is more deeply recessed into the plane of the face than is typical. Evidence: PCS. Frequency: 1/1. (PMID:25604084)
- Global developmental delay (HP:0001263): A delay in the achievement of motor or mental milestones in the domains of development of a child, including motor skills, speech and language, cognitive skills, and social and emotional skills. This term should only be used to describe children younger than five years of age. Evidence: PCS. Frequency: 1/1. (PMID:25604084)
- Autosomal recessive inheritance (HP:0000007): A mode of inheritance that is observed for traits related to a gene encoded on one of the autosomes (i.e., the human chromosomes 1-22) in which a trait manifests in individuals with two pathogenic alleles, either homozygotes (two copies of the same mutant allele) or compound heterozygotes (whereby each copy of a gene has a distinct mutant allele). Evidence: PCS. (PMID:25604084)
- Decreased activity of mitochondrial complex IV (HP:0008347): A reduction in the activity of the mitochondrial respiratory chain complex IV, which is part of the electron transport chain in mitochondria. Evidence: PCS. Frequency: 1/1. (PMID:25604084)
- Obesity (HP:0001513): Accumulation of substantial excess body fat. Evidence: PCS. Frequency: 1/1. (PMID:25604084)
- Cytochrome C oxidase-negative muscle fibers (HP:0003688): An abnormally reduced activity of the enzyme cytochrome C oxidase in muscle tissue. Evidence: PCS. Frequency: 1/1. (PMID:25604084)
- Exercise intolerance (HP:0003546): A functional motor deficit where individuals whose responses to the challenges of exercise fail to achieve levels considered normal for their age and gender. Evidence: PCS. Frequency: 1/1. (PMID:25604084)